- Dystonia (HP:0001332): An abnormally increased muscular tone that causes fixed abnormal postures. There is a slow, intermittent twisting motion that leads to exaggerated turning and posture of the extremities and trunk. Evidence: PCS. Frequency: 1/1. (PMID:12742592)
- Hypoplasia of the corpus callosum (HP:0002079): Underdevelopment of the corpus callosum. Evidence: TAS. Frequency: Occasional (HP:0040283). (OMIM:613720)
- Seizure (HP:0001250): A seizure is an intermittent abnormality of nervous system physiology characterized by a transient occurrence of signs and/or symptoms due to abnormal excessive or synchronous neuronal activity in the brain. Evidence: PCS. Frequency: 1/1. (PMID:12742592)
- Global developmental delay (HP:0001263): A delay in the achievement of motor or mental milestones in the domains of development of a child, including motor skills, speech and language, cognitive skills, and social and emotional skills. This term should only be used to describe children younger than five years of age. Evidence: PCS. Frequency: 1/1. (PMID:12742592)
- Spastic tetraparesis (HP:0001285): Spastic weakness affecting all four limbs. Evidence: TAS. (OMIM:613720)
- Hypotonia (HP:0001252): Hypotonia is an abnormally low muscle tone (the amount of tension or resistance to movement in a muscle). Even when relaxed, muscles have a continuous and passive partial contraction which provides some resistance to passive stretching. Hypotonia thus manifests as diminished resistance to passive stretching. Hypotonia is not the same as muscle weakness, although the two conditions can co-exist. Evidence: PCS. Frequency: 1/1. (PMID:12742592)
- Infantile onset (HP:0003593): Onset of signs or symptoms of disease between 28 days to one year of life. Evidence: TAS. (OMIM:613720)
- EEG with burst suppression (HP:0010851): The burst suppression pattern in electroencephalography refers to a characteristic periodic pattern of low voltage (<10 microvolts) suppressed background and a relatively shorter pattern of higher amplitude slow, sharp, and spiking complexes. Evidence: PCS. Frequency: 1/1. (PMID:12742592)
- Epileptic encephalopathy (HP:0200134): A condition in which epileptiform abnormalities are believed to contribute to the progressive disturbance in cerebral function. Epileptic encephalaopathy is characterized by (1) electrographic EEG paroxysmal activity that is often aggressive, (2) seizures that are usually multiform and intractable, (3) cognitive, behavioral and neurological deficits that may be relentless, and (4) sometimes early death. Evidence: PCS. Frequency: 1/1. (PMID:12742592)
- Autosomal dominant inheritance (HP:0000006): A mode of inheritance that is observed for traits related to a gene encoded on one of the autosomes (i.e., the human chromosomes 1-22) in which a trait manifests in heterozygotes. In the context of medical genetics, an autosomal dominant disorder is caused when a single copy of the mutant allele is present. Males and females are affected equally, and can both transmit the disorder with a risk of 50% for each child of inheriting the mutant allele. Evidence: PCS. (PMID:12742592)
- Intellectual disability (HP:0001249): The term intellectual disability or intellectual developmental disorder is used to describe significantly sub-average intellectual and adaptive functioning based on clinical assessment and as measured by individually administered, appropriately normed, standardized and validated tests of intellectual functioning and adaptive behavior, with onset during the developmental period from infancy through adolescence. Evidence: TAS. (OMIM:613720)
- Neonatal onset (HP:0003623): Onset of signs or symptoms of disease within the first 28 days of life. Evidence: PCS. Frequency: 1/1. (PMID:12742592)
These phenotypes are associated with the disease developmental and epileptic encephalopathy, 7 (OMIM:613720).